- Loose anagen hair (HP:0040169). Evidence: IEA. (OMIM:600628)
- Juvenile onset (HP:0003621): Onset of signs or symptoms of disease between the age of 5 and 15 years. Evidence: IEA. (OMIM:600628)
- Fair hair (HP:0002286): A lesser degree of hair pigmentation than would otherwise be expected. Evidence: TAS. (OMIM:600628)
- Childhood onset (HP:0011463): Onset of disease at the age of between 1 and 5 years. Evidence: TAS. (OMIM:600628)
- Sparse hair (HP:0008070): Reduced density of hairs. Evidence: TAS. (OMIM:600628)
- Autosomal dominant inheritance (HP:0000006): A mode of inheritance that is observed for traits related to a gene encoded on one of the autosomes (i.e., the human chromosomes 1-22) in which a trait manifests in heterozygotes. In the context of medical genetics, an autosomal dominant disorder is caused when a single copy of the mutant allele is present. Males and females are affected equally, and can both transmit the disorder with a risk of 50% for each child of inheriting the mutant allele. Evidence: TAS. (OMIM:600628)
These phenotypes are associated with the disease loose anagen syndrome (OMIM:600628).